Phenotypes associated with the disease Asherman syndrome (ORPHA:137686, an Orphanet rare-disease identifier):
- Abnormality of the menstrual cycle (HP:0000140, a Human Phenotype Ontology term): An abnormality of the ovulation cycle. Evidence: TAS. Frequency: Frequent (HP:0040282, a Human Phenotype Ontology term). (ORPHA:137686)
- Decreased fertility in females (HP:0000868, a Human Phenotype Ontology term). Evidence: TAS. Frequency: Frequent (HP:0040282, a Human Phenotype Ontology term). (ORPHA:137686)
- Oligomenorrhea (HP:0000876, a Human Phenotype Ontology term): Infrequent menses (less than 6 per year or more than 35 days between cycles). Evidence: TAS. Frequency: Frequent (HP:0040282, a Human Phenotype Ontology term). (ORPHA:137686)
- Infertility (HP:0000789, a Human Phenotype Ontology term). Evidence: TAS. Frequency: Occasional (HP:0040283, a Human Phenotype Ontology term). (ORPHA:137686)
- Secondary amenorrhea (HP:0000869, a Human Phenotype Ontology term). Evidence: TAS. Frequency: Occasional (HP:0040283, a Human Phenotype Ontology term). (ORPHA:137686)
- Episodic abdominal pain (HP:0002574, a Human Phenotype Ontology term): An intermittent form of abdominal pain. Evidence: TAS. Frequency: Occasional (HP:0040283, a Human Phenotype Ontology term). (ORPHA:137686)
- Miscarriage (HP:0005268, a Human Phenotype Ontology term): A pregnancy that ends at a stage in which the fetus is incapable of surviving on its own, defined as the spontaneous loss of a fetus before the 22th week of pregnancy. Evidence: TAS. Frequency: Occasional (HP:0040283, a Human Phenotype Ontology term). (ORPHA:137686)
- Dysmenorrhea (HP:0100607, a Human Phenotype Ontology term): Pain during menstruation that interferes with daily activities. Evidence: TAS. Frequency: Occasional (HP:0040283, a Human Phenotype Ontology term). (ORPHA:137686)
- Metrorrhagia (HP:0100608, a Human Phenotype Ontology term): Bleeding at irregular intervals. Evidence: TAS. Frequency: Occasional (HP:0040283, a Human Phenotype Ontology term). (ORPHA:137686)
- Chronic infection (HP:0031035, a Human Phenotype Ontology term): Presence of a protracted or persistent infection by a pathogen potentially related to an underlying abnormality of the immune system that is not able to clear the infection. Evidence: TAS. Frequency: Very rare (HP:0040284, a Human Phenotype Ontology term). (ORPHA:137686)
- Abnormal placenta morphology (HP:0100767, a Human Phenotype Ontology term): An abnormality of the placenta, the organ that connects the developing fetus to the uterine wall to enable nutrient uptake, waste elimination, and gas exchange. Evidence: TAS. Frequency: Very rare (HP:0040284, a Human Phenotype Ontology term). (ORPHA:137686)